- Bronchial cartilage hypoplasia (HP:0006539). Evidence: IEA. (OMIM:130710)
- Respiratory distress (HP:0002098): Respiratory distress is objectively observable as the physical or emotional consequences from the experience of dyspnea. The physical presentation of respiratory distress is generally referred to as labored breathing, while the sensation of respiratory distress is called shortness of breath or dyspnea. Evidence: IEA. (OMIM:130710)
- Autosomal dominant inheritance (HP:0000006): A mode of inheritance that is observed for traits related to a gene encoded on one of the autosomes (i.e., the human chromosomes 1-22) in which a trait manifests in heterozygotes. In the context of medical genetics, an autosomal dominant disorder is caused when a single copy of the mutant allele is present. Males and females are affected equally, and can both transmit the disorder with a risk of 50% for each child of inheriting the mutant allele. Evidence: IEA. (OMIM:130710)
These phenotypes are associated with the disease congenital lobar emphysema (OMIM:130710).